Phenotypes associated with the disease thymoma, familial (OMIM:274230):
- Neoplasm (HP:0002664): An organ or organ-system abnormality that consists of uncontrolled autonomous cell-proliferation which can occur in any part of the body as a benign or malignant neoplasm (tumor). Evidence: IEA. (OMIM:274230)
- Thymoma (HP:0100522): A tumor originating from the epithelial cells of the thymus. Evidence: TAS. (OMIM:274230)
- Typified by somatic mosaicism (HP:0001442): Description of conditions in which affected individuals typically display somatic mosaicism, i.e., genetically distinct populations of somatic cells in a given organism caused by DNA mutations, epigenetic alterations of DNA, chromosomal abnormalities or the spontaneous reversion of inherited mutations. In many conditions typified by somatic mosaicism, constitutive mutation is lethal and cases are exclusively or predominantly mosaic. Evidence: TAS. (OMIM:274230)
- Autosomal recessive inheritance (HP:0000007): A mode of inheritance that is observed for traits related to a gene encoded on one of the autosomes (i.e., the human chromosomes 1-22) in which a trait manifests in individuals with two pathogenic alleles, either homozygotes (two copies of the same mutant allele) or compound heterozygotes (whereby each copy of a gene has a distinct mutant allele). Evidence: IEA. (OMIM:274230)
- Respiratory insufficiency (HP:0002093). Evidence: IEA. (OMIM:274230)